Phenotypes associated with the disease primary ciliary dyskinesia 27 (OMIM:615504):
- Situs inversus totalis (HP:0001696): A left-right reversal (or mirror reflection) of the anatomical location of the major thoracic and abdominal organs. Evidence: PCS. Frequency: 0/3. (PMID:24094744)
- Bronchiectasis (HP:0002110): Persistent abnormal dilatation of the bronchi owing to localized and irreversible destruction and widening of the large airways. Evidence: PCS. Frequency: 4/4. (PMID:24094744;PMID:23991085)
- Infantile onset (HP:0003593): Onset of signs or symptoms of disease between 28 days to one year of life. Evidence: PCS. Frequency: 1/1. (PMID:23991085)
- Decreased nasal nitric oxide (HP:0033036): Reduced level of nasal nitric oxide (nNO). Current American Thoracic Society/European Respiratory Society (ATS/ERS) guidelines for nNO measurements recommend air aspiration via a nasal probe while the subject exhales through the mouth against resistance in order to maintain velum closure. Evidence: PCS. Frequency: 3/3. (PMID:24094744;PMID:23991085)
- Chronic sinusitis (HP:0011109): A chronic form of sinusitis. Evidence: PCS. Frequency: 2/3. (PMID:24094744)
- Recurrent sinusitis (HP:0011108): A recurrent form of sinusitis. Evidence: TAS. (OMIM:615504)
- Respiratory insufficiency due to defective ciliary clearance (HP:0200073). Evidence: TAS. (OMIM:615504)
- Ciliary dyskinesia (HP:0012265): A deviation from the normally well coordinated pattern of intracellular and intercellular synchrony of motile cilia. Dyskinetic cilia usually beat out of synchrony relative to neighboring cilia. Evidence: PCS. (PMID:24094744)
- Rhinitis (HP:0012384): Inflammation of the nasal mucosa with nasal congestion. Evidence: TAS. (OMIM:615504)
- Recurrent otitis media (HP:0000403): Increased susceptibility to otitis media, as manifested by recurrent episodes of otitis media. Evidence: PCS. Frequency: 3/3. (PMID:24094744)
- Autosomal recessive inheritance (HP:0000007): A mode of inheritance that is observed for traits related to a gene encoded on one of the autosomes (i.e., the human chromosomes 1-22) in which a trait manifests in individuals with two pathogenic alleles, either homozygotes (two copies of the same mutant allele) or compound heterozygotes (whereby each copy of a gene has a distinct mutant allele). Evidence: PCS. (PMID:24094744)
- Recurrent respiratory infections (HP:0002205): An increased susceptibility to respiratory infections as manifested by a history of recurrent respiratory infections. Evidence: PCS. Frequency: 1/1. (PMID:23991085)
- Neonatal respiratory distress (HP:0002643): Respiratory difficulty as newborn. Evidence: PCS. Frequency: 1/3. Onset: Neonatal onset (HP:0003623). (PMID:24094744)
- Chronic bronchitis (HP:0004469): Chronic inflammation of the bronchi. Evidence: PCS. (PMID:24094744)